Phenotypes associated with the disease Hypotonia-speech impairment-severe cognitive delay syndrome (ORPHA:371364):
- Strabismus (HP:0000486): A misalignment of the eyes so that the visual axes deviate from bifoveal fixation. The classification of strabismus may be based on a number of features including the relative position of the eyes, whether the deviation is latent or manifest, intermittent or constant, concomitant or otherwise and according to the age of onset and the relevance of any associated refractive error. Evidence: TAS. Frequency: Very frequent (HP:0040281). (ORPHA:371364)
- Esotropia (HP:0000565): A form of strabismus with one or both eyes turned inward ('crossed') to a relatively severe degree, usually defined as 10 diopters or more. Evidence: TAS. Frequency: Very frequent (HP:0040281). (ORPHA:371364)
- Delayed speech and language development (HP:0000750): A degree of language development that is significantly below the norm for a child of a specified age. Evidence: TAS. Frequency: Very frequent (HP:0040281). (ORPHA:371364)
- Global developmental delay (HP:0001263): A delay in the achievement of motor or mental milestones in the domains of development of a child, including motor skills, speech and language, cognitive skills, and social and emotional skills. This term should only be used to describe children younger than five years of age. Evidence: TAS. Frequency: Very frequent (HP:0040281). (ORPHA:371364)
- Motor delay (HP:0001270): A type of Developmental delay characterized by a delay in acquiring motor skills. Evidence: TAS. Frequency: Very frequent (HP:0040281). (ORPHA:371364)
- Absent speech (HP:0001344): Complete lack of development of speech and language abilities. Evidence: TAS. Frequency: Very frequent (HP:0040281). (ORPHA:371364)
- Floppy infant (HP:0008947): Floppiness/hypotonia is defined as reduced resistance to passive movement of joints. Physical examination of floppy/hypotonic infants shows head lag, lack of shoulder and elbow muscle contraction on traction response, inability to tighten the shoulder girdle muscles (or slipping through) when held under the axillae, scarf sign (when the arm is pulled to the opposite side, the arm wraps around the neck with the elbow crossing midline), hyperdorsiflexion of the feet, easy apposition of the thumb against the forearm, feet touching the cheek with ease and without discomfort, frog leg position, and inverted U sign on ventral suspension (head, arms, and legs hanging down without elbow or knee flexion and the trunk rounded in a dome shape). Evidence: TAS. Frequency: Very frequent (HP:0040281). (ORPHA:371364)
- Tapered distal phalanges of finger (HP:0009884): A reduction in diameter of the distal phalanx of finger towards the distal end. Evidence: TAS. Frequency: Very frequent (HP:0040281). (ORPHA:371364)
- Severe intellectual disability (HP:0010864): Severe intellectual disability (ID) is defined as a type of ID characterized by severely sub-average adaptive functioning and intellectual functioning, with an intelligence quotient (IQ) the range of 20-34. Evidence: TAS. Frequency: Very frequent (HP:0040281). (ORPHA:371364)
- Thin upper lip vermilion (HP:0000219): Height of the vermilion of the upper lip in the midline more than 2 SD below the mean. Alternatively, an apparently reduced height of the vermilion of the upper lip in the frontal view (subjective). Evidence: TAS. Frequency: Frequent (HP:0040282). (ORPHA:371364)
- Microcephaly (HP:0000252): Head circumference below 2 standard deviations below the mean for age and gender. Evidence: TAS. Frequency: Frequent (HP:0040282). (ORPHA:371364)
- Smooth philtrum (HP:0000319): Flat skin surface, with no ridge formation in the central region of the upper lip between the nasal base and upper vermilion border. Evidence: TAS. Frequency: Frequent (HP:0040282). (ORPHA:371364)
- Short philtrum (HP:0000322): Distance between nasal base and midline upper lip vermilion border more than 2 SD below the mean. Alternatively, an apparently decreased distance between nasal base and midline upper lip vermilion border. Evidence: TAS. Frequency: Frequent (HP:0040282). (ORPHA:371364)
- Triangular face (HP:0000325): Facial contour, as viewed from the front, triangular in shape, with breadth at the temples and tapering to a narrow chin. Evidence: TAS. Frequency: Frequent (HP:0040282). (ORPHA:371364)
- Micrognathia (HP:0000347): Developmental hypoplasia of the mandible. Evidence: TAS. Frequency: Frequent (HP:0040282). (ORPHA:371364)
- Posteriorly rotated ears (HP:0000358): A type of abnormal location of the ears in which the position of the ears is characterized by posterior rotation (the superior part of the ears is rotated towards the back of the head, and the inferior part of the ears towards the front). Evidence: TAS. Frequency: Frequent (HP:0040282). (ORPHA:371364)
- Prominent nasal bridge (HP:0000426): Anterior positioning of the nasal root in comparison to the usual positioning for age. Evidence: TAS. Frequency: Frequent (HP:0040282). (ORPHA:371364)
- Wide nasal bridge (HP:0000431): Increased breadth of the nasal bridge (and with it, the nasal root). Evidence: TAS. Frequency: Frequent (HP:0040282). (ORPHA:371364)
- Anteverted nares (HP:0000463): Anteriorly-facing nostrils viewed with the head in the Frankfurt horizontal and the eyes of the observer level with the eyes of the subject. This gives the appearance of an upturned nose (upturned nasal tip). Evidence: TAS. Frequency: Frequent (HP:0040282). (ORPHA:371364)
- Downslanted palpebral fissures (HP:0000494): The palpebral fissure inclination is more than two standard deviations below the mean. Evidence: TAS. Frequency: Frequent (HP:0040282). (ORPHA:371364)
- Arachnodactyly (HP:0001166): Abnormally long and slender fingers (spider fingers). Evidence: TAS. Frequency: Frequent (HP:0040282). (ORPHA:371364)
- Seizure (HP:0001250): A seizure is an intermittent abnormality of nervous system physiology characterized by a transient occurrence of signs and/or symptoms due to abnormal excessive or synchronous neuronal activity in the brain. Evidence: TAS. Frequency: Frequent (HP:0040282). (ORPHA:371364)
- Hypotonia (HP:0001252): Hypotonia is an abnormally low muscle tone (the amount of tension or resistance to movement in a muscle). Even when relaxed, muscles have a continuous and passive partial contraction which provides some resistance to passive stretching. Hypotonia thus manifests as diminished resistance to passive stretching. Hypotonia is not the same as muscle weakness, although the two conditions can co-exist. Evidence: TAS. Frequency: Frequent (HP:0040282). (ORPHA:371364)
- Neonatal hypotonia (HP:0001319): Muscular hypotonia (abnormally low muscle tone) manifesting in the neonatal period. Evidence: TAS. Frequency: Frequent (HP:0040282). (ORPHA:371364)
- Plagiocephaly (HP:0001357): Asymmetric head shape, which is usually a combination of unilateral occipital flattening with ipsilateral frontal prominence, leading to rhomboid cranial shape. Evidence: TAS. Frequency: Frequent (HP:0040282). (ORPHA:371364)
- Severe failure to thrive (HP:0001525). Evidence: TAS. Frequency: Frequent (HP:0040282). (ORPHA:371364)
- Talipes equinovarus (HP:0001762): Talipes equinovarus (also called clubfoot) typically has four main components: inversion and adduction of the forefoot; inversion of the heel and hindfoot; equinus (limitation of extension) of the ankle and subtalar joint; and internal rotation of the leg. Evidence: TAS. Frequency: Frequent (HP:0040282). (ORPHA:371364)
- Abnormal facial shape (HP:0001999): An abnormal morphology (form) of the face or its components. Evidence: TAS. Frequency: Frequent (HP:0040282). (ORPHA:371364)
- Frontal bossing (HP:0002007): Bilateral bulging of the lateral frontal bone prominences with relative sparing of the midline. Evidence: TAS. Frequency: Frequent (HP:0040282). (ORPHA:371364)
- Constipation (HP:0002019): Infrequent or difficult evacuation of feces. Evidence: TAS. Frequency: Frequent (HP:0040282). (ORPHA:371364)
- EEG abnormality (HP:0002353): Abnormality observed by electroencephalogram (EEG), which is used to record of the brain's spontaneous electrical activity from multiple electrodes placed on the scalp. Evidence: TAS. Frequency: Frequent (HP:0040282). (ORPHA:371364)
- Scoliosis (HP:0002650): The presence of an abnormal lateral curvature of the spine. Evidence: TAS. Frequency: Frequent (HP:0040282). (ORPHA:371364)
- Short stature (HP:0004322): A height below that which is expected according to age and gender norms. Although there is no universally accepted definition of short stature, many refer to "short stature" as height more than 2 standard deviations below the mean for age and gender (or below the 3rd percentile for age and gender dependent norms). Evidence: TAS. Frequency: Frequent (HP:0040282). (ORPHA:371364)
- Cachexia (HP:0004326): Severe weight loss, wasting of muscle, loss of appetite, and general debility related to a chronic disease. Evidence: TAS. Frequency: Frequent (HP:0040282). (ORPHA:371364)
- Enlarged naris (HP:0009931): Increased aperture of the nostril. Evidence: TAS. Frequency: Frequent (HP:0040282). (ORPHA:371364)
- Tented upper lip vermilion (HP:0010804): Triangular appearance of the oral aperture with the apex in the midpoint of the upper vermilion and the lower vermilion forming the base. Evidence: TAS. Frequency: Frequent (HP:0040282). (ORPHA:371364)
- Feeding difficulties (HP:0011968): Impaired ability to eat related to problems gathering food and getting ready to suck, chew, or swallow it. Evidence: TAS. Frequency: Frequent (HP:0040282). (ORPHA:371364)
- Dyskinesia (HP:0100660): A movement disorder which consists of effects including diminished voluntary movements and the presence of involuntary movements. Evidence: TAS. Frequency: Frequent (HP:0040282). (ORPHA:371364)
- Hyperesthesia (HP:0100963): Increased sensitivity to stimulation, excluding the special senses, which may refer to various modes of cutaneous sensibility including touch and thermal sensation without pain, as well as to pain. Evidence: TAS. Frequency: Frequent (HP:0040282). (ORPHA:371364)
- Small hand (HP:0200055): Disproportionately small hand. Evidence: TAS. Frequency: Frequent (HP:0040282). (ORPHA:371364)
- Short neck (HP:0000470): Diminished length of the neck. Evidence: TAS. Frequency: Occasional (HP:0040283). (ORPHA:371364)
- Nystagmus (HP:0000639): Rhythmic, involuntary oscillations of one or both eyes related to abnormality in fixation, conjugate gaze, or vestibular mechanisms. Evidence: TAS. Frequency: Occasional (HP:0040283). (ORPHA:371364)
- Intrauterine growth retardation (HP:0001511): An abnormal restriction of fetal growth with fetal weight below the tenth percentile for gestational age. Evidence: TAS. Frequency: Occasional (HP:0040283). (ORPHA:371364)
- Hypoplasia of the corpus callosum (HP:0002079): Underdevelopment of the corpus callosum. Evidence: TAS. Frequency: Occasional (HP:0040283). (ORPHA:371364)
- Sleep disturbance (HP:0002360): An abnormal pattern in the quality, quantity, or characteristics of sleep. Evidence: TAS. Frequency: Occasional (HP:0040283). (ORPHA:371364)
- Spastic tetraplegia (HP:0002510): Spastic paralysis affecting all four limbs. Evidence: TAS. Frequency: Occasional (HP:0040283). (ORPHA:371364)
- Obstructive sleep apnea (HP:0002870): Obstructive Sleep Apnea is a condition characterized by the obstruction of the airway and pauses in breathing during sleep, which occur multiple times throughout the night. It is related to the relaxation of muscle tone that typically happens during sleep, leading to a partial collapse of the soft tissues in the airway and causing airflow obstruction. Evidence: TAS. Frequency: Occasional (HP:0040283). (ORPHA:371364)
- Elbow flexion contracture (HP:0002987): An elbow contracture that limits the ability of the elbow joint to be extended (straightened), meaning that the elbow is fixed in an flexed (bent) position. Evidence: TAS. Frequency: Occasional (HP:0040283). (ORPHA:371364)
- Hip contracture (HP:0003273): Lack of full passive range of motion (restrictions in flexion, extension, or other movements) of the hip joint resulting from structural changes of non-bony tissues, such as muscles, tendons, ligaments, joint capsules and/or skin. Evidence: TAS. Frequency: Occasional (HP:0040283). (ORPHA:371364)
- EMG: myopathic abnormalities (HP:0003458): The presence of abnormal electromyographic patterns indicative of myopathy, such as small-short polyphasic motor unit potentials. Evidence: TAS. Frequency: Occasional (HP:0040283). (ORPHA:371364)
- Knee flexion contracture (HP:0006380): A type of knee joint contracture in which the knee is in a fixed bent (flexed) configuration such that it cannot be straightened actively or passively. Evidence: TAS. Frequency: Occasional (HP:0040283). (ORPHA:371364)
- Axial hypotonia (HP:0008936): Muscular hypotonia (abnormally low muscle tone) affecting the musculature of the trunk. Evidence: TAS. Frequency: Occasional (HP:0040283). (ORPHA:371364)
- Nasogastric tube feeding in infancy (HP:0011470): Feeding problem necessitating nasogastric tube feeding. Evidence: TAS. Frequency: Occasional (HP:0040283). (ORPHA:371364)
- Conspicuously happy disposition (HP:0100024): An unusually happy demeanor over time, which can also be observed during inappropriate situations that should, for example, cause distress, fear, or anger. Evidence: TAS. Frequency: Occasional (HP:0040283). (ORPHA:371364)
- Self-injurious behavior (HP:0100716): Self-aggression. Evidence: TAS. Frequency: Occasional (HP:0040283). (ORPHA:371364)